Phenotypes associated with the disease congenital velopharyngeal incompetence (OMIM:167500):
- Velopharyngeal insufficiency (HP:0000220): Inability of velopharyngeal sphincter to sufficiently separate the nasal cavity from the oral cavity during speech. Evidence: TAS. (OMIM:167500)
- Cleft palate (HP:0000175): Cleft palate is a developmental defect of the palate resulting from a failure of fusion of the palatine processes and manifesting as a separation of the roof of the mouth (soft and hard palate). Evidence: IEA. (OMIM:167500)
- Abnormality of the voice (HP:0001608). Evidence: TAS. (OMIM:167500)
- Non-Mendelian inheritance (HP:0001426): A mode of inheritance that depends on genetic determinants in more than one gene. Evidence: TAS. (OMIM:167500)